Phenotypes associated with the disease cornea guttata with anterior polar cataracts (OMIM:121390):
- Anterior polar cataract (HP:0001134): A polar cataract that affects the anterior pole of the lens. Evidence: IEA. (OMIM:121390)
- Visual impairment (HP:0000505): Visual impairment (or vision impairment) is vision loss (of a person) to such a degree as to qualify as an additional support need through a significant limitation of visual capability resulting from either disease, trauma, or congenital or degenerative conditions that cannot be corrected by conventional means, such as refractive correction, medication, or surgery. Evidence: IEA. (OMIM:121390)
- Autosomal dominant inheritance (HP:0000006): A mode of inheritance that is observed for traits related to a gene encoded on one of the autosomes (i.e., the human chromosomes 1-22) in which a trait manifests in heterozygotes. In the context of medical genetics, an autosomal dominant disorder is caused when a single copy of the mutant allele is present. Males and females are affected equally, and can both transmit the disorder with a risk of 50% for each child of inheriting the mutant allele. Evidence: IEA. (OMIM:121390)